Phenotypes associated with the disease hereditary spastic paraplegia 25 (OMIM:608220):
- Spinal cord compression (HP:0002176): External mechanical compression of the spinal cord. Evidence: IEA. (OMIM:608220)
- Autosomal recessive inheritance (HP:0000007): A mode of inheritance that is observed for traits related to a gene encoded on one of the autosomes (i.e., the human chromosomes 1-22) in which a trait manifests in individuals with two pathogenic alleles, either homozygotes (two copies of the same mutant allele) or compound heterozygotes (whereby each copy of a gene has a distinct mutant allele). Evidence: TAS. (OMIM:608220)
- Back pain (HP:0003418): An unpleasant sensation characterized by physical discomfort (such as pricking, throbbing, or aching) localized to the back. Evidence: TAS. (OMIM:608220)
- Spastic paraplegia (HP:0001258): Complete loss of the ability to move the lower limbs accompanied by spasticity of the lower limbs. Evidence: TAS. (OMIM:608220)
- Neck pain (HP:0030833): An unpleasant sensation characterized by physical discomfort (such as pricking, throbbing, or aching) localized to the neck. Evidence: TAS. (OMIM:608220)